- Typified by somatic mosaicism (HP:0001442): Description of conditions in which affected individuals typically display somatic mosaicism, i.e., genetically distinct populations of somatic cells in a given organism caused by DNA mutations, epigenetic alterations of DNA, chromosomal abnormalities or the spontaneous reversion of inherited mutations. In many conditions typified by somatic mosaicism, constitutive mutation is lethal and cases are exclusively or predominantly mosaic. Evidence: IEA. (OMIM:151380)
- Acute monocytic leukemia (HP:0004845): The accumulation of transformed primitive hematopoietic blast cells, which lose their ability of normal differentiation and proliferation. Evidence: IEA. (OMIM:151380)
These phenotypes are associated with the disease acute monocytic leukemia (OMIM:151380).